- T-wave inversion in the right precordial leads (HP:0003140). Evidence: TAS. (OMIM:602087)
- Ventricular arrhythmia (HP:0004308). Evidence: TAS. (OMIM:602087)
- Right ventricular cardiomyopathy (HP:0011663): Right ventricular dysfunction (global or regional) with functional and morphological right ventricular abnormalities, with or without left ventricular disease. Evidence: TAS. (OMIM:602087)
- Focal necrosis of right ventricular muscle cells (HP:0003338). Evidence: TAS. (OMIM:602087)
- Autosomal dominant inheritance (HP:0000006): A mode of inheritance that is observed for traits related to a gene encoded on one of the autosomes (i.e., the human chromosomes 1-22) in which a trait manifests in heterozygotes. In the context of medical genetics, an autosomal dominant disorder is caused when a single copy of the mutant allele is present. Males and females are affected equally, and can both transmit the disorder with a risk of 50% for each child of inheriting the mutant allele. Evidence: TAS. (OMIM:602087)
- Sudden death (HP:0001699): Rapid and unexpected death. Evidence: TAS. (OMIM:602087)
These phenotypes are associated with the disease arrhythmogenic right ventricular dysplasia 4 (OMIM:602087).